Phenotypes associated with the disease intussusception (OMIM:147710):
- Intussusception (HP:0002576): An abnormality of the intestine in which part of the intestine invaginates (telescopes) into another part of the intestine. Evidence: IEA. (OMIM:147710)
- Autosomal dominant inheritance (HP:0000006): A mode of inheritance that is observed for traits related to a gene encoded on one of the autosomes (i.e., the human chromosomes 1-22) in which a trait manifests in heterozygotes. In the context of medical genetics, an autosomal dominant disorder is caused when a single copy of the mutant allele is present. Males and females are affected equally, and can both transmit the disorder with a risk of 50% for each child of inheriting the mutant allele. Evidence: IEA. (OMIM:147710)